Phenotypes associated with the disease Narcolepsy type 2 (ORPHA:83465):
- Atypical behavior (HP:0000708): Atypical behavior is an abnormality in a person's actions that can be controlled or modulated by the will of the individual. While abnormal behaviors can be difficult to control, they are distinct from other abnormal actions that cannot be affected by the individual's will. Evidence: TAS. Frequency: Occasional (HP:0040283). (ORPHA:83465)
- Hallucinations (HP:0000738): Perceptions in a conscious and awake state that, in the absence of external stimuli, have qualities of real perception. These perceptions are vivid, substantial, and located in external objective space. Evidence: TAS. Frequency: Very frequent (HP:0040281). (ORPHA:83465)
- Excessive daytime somnolence (HP:0001262): A state of abnormally strong desire for sleep during the daytime. Evidence: TAS. Frequency: Very frequent (HP:0040281). (ORPHA:83465)
- Sleep disturbance (HP:0002360): An abnormal pattern in the quality, quantity, or characteristics of sleep. Evidence: TAS. Frequency: Very frequent (HP:0040281). (ORPHA:83465)
- Insomnia (HP:0100785): Persistent difficulty in starting or maintaining sleep, or waking up earlier than desired, despite having adequate opportunities and conditions for sleep. Evidence: TAS. Frequency: Very frequent (HP:0040281). (ORPHA:83465)